- Chronic lymphatic leukemia (HP:0005550): A chronic lymphocytic/lymphatic/lymphoblastic leukemia (CLL) is a neoplastic disease characterized by proliferation and accumulation (blood, marrow and lymphoid organs) of morphologically mature but immunologically dysfunctional lymphocytes. A CLL is always a B-cell lymphocytic leukemia as there are no reports of cases of T-cell lymphocytic leukemias. Evidence: IEA. (OMIM:109543)
- Autosomal dominant inheritance (HP:0000006): A mode of inheritance that is observed for traits related to a gene encoded on one of the autosomes (i.e., the human chromosomes 1-22) in which a trait manifests in heterozygotes. In the context of medical genetics, an autosomal dominant disorder is caused when a single copy of the mutant allele is present. Males and females are affected equally, and can both transmit the disorder with a risk of 50% for each child of inheriting the mutant allele. Evidence: IEA. (OMIM:109543)
These phenotypes are associated with the disease leukemia, chronic lymphocytic, susceptibility to, 2 (OMIM:109543).